- Renal insufficiency (HP:0000083): A reduction in the level of performance of the kidneys in areas of function comprising the concentration of urine, removal of wastes, the maintenance of electrolyte balance, homeostasis of blood pressure, and calcium metabolism. Evidence: TAS. Frequency: Occasional (HP:0040283). (ORPHA:1563)
- Nephropathy (HP:0000112): A nonspecific term referring to disease or damage of the kidneys. Evidence: TAS. Frequency: Very frequent (HP:0040281). (ORPHA:1563)
- Wide nasal bridge (HP:0000431): Increased breadth of the nasal bridge (and with it, the nasal root). Evidence: TAS. Frequency: Very frequent (HP:0040281). (ORPHA:1563)
- Telecanthus (HP:0000506): Distance between the inner canthi more than two standard deviations above the mean (objective); or, apparently increased distance between the inner canthi. Evidence: TAS. Frequency: Very frequent (HP:0040281). (ORPHA:1563)
- Cataract (HP:0000518): A cataract is an opacity or clouding that develops in the crystalline lens of the eye or in its capsule. Evidence: TAS. Frequency: Frequent (HP:0040282). (ORPHA:1563)
- Hypothyroidism (HP:0000821): Deficiency of thyroid hormone. Evidence: TAS. Frequency: Very frequent (HP:0040281). (ORPHA:1563)
- Hypoparathyroidism (HP:0000829): A condition caused by a deficiency of parathyroid hormone characterized by hypocalcemia and hyperphosphatemia. Evidence: TAS. Frequency: Very frequent (HP:0040281). (ORPHA:1563)
- Hypohidrosis (HP:0000966): Abnormally diminished capacity to sweat. Evidence: TAS. Frequency: Very frequent (HP:0040281). (ORPHA:1563)
- Lymphedema (HP:0001004): Localized fluid retention and tissue swelling caused by a compromised lymphatic system. Evidence: TAS. Frequency: Very frequent (HP:0040281). (ORPHA:1563)
- Thickened skin (HP:0001072): Laminar thickening of skin. Evidence: TAS. Frequency: Very frequent (HP:0040281). (ORPHA:1563)
- Brachydactyly (HP:0001156): Digits that appear disproportionately short compared to the hand/foot. The word brachydactyly is used here to describe a series distinct patterns of shortened digits (brachydactyly types A-E). This is the sense used here. Evidence: TAS. Frequency: Very frequent (HP:0040281). (ORPHA:1563)
- Mitral valve prolapse (HP:0001634): One or both of the leaflets (cusps) of the mitral valve bulges back into the left atrium upon contraction of the left ventricle. Evidence: TAS. Frequency: Very frequent (HP:0040281). (ORPHA:1563)
- Anonychia (HP:0001798): Aplasia of the nail. Evidence: TAS. Frequency: Very frequent (HP:0040281). (ORPHA:1563)
- Generalized hirsutism (HP:0002230): Abnormally increased hair growth over much of the entire body. Evidence: TAS. Frequency: Very frequent (HP:0040281). (ORPHA:1563)
- Hypocalcemia (HP:0002901): The concentration of calcium in the blood circulation is below the lower limit of normal. Evidence: TAS. Frequency: Very frequent (HP:0040281). (ORPHA:1563)
- Short stature (HP:0004322): A height below that which is expected according to age and gender norms. Although there is no universally accepted definition of short stature, many refer to "short stature" as height more than 2 standard deviations below the mean for age and gender (or below the 3rd percentile for age and gender dependent norms). Evidence: TAS. Frequency: Very frequent (HP:0040281). (ORPHA:1563)
- Short distal phalanx of finger (HP:0009882): Short distance from the end of the finger to the most distal interphalangeal crease or the distal interphalangeal joint flexion point. That is, hypoplasia of one or more of the distal phalanx of finger. Evidence: TAS. Frequency: Very frequent (HP:0040281). (ORPHA:1563)
These phenotypes are associated with the disease Dahlberg-Borer-Newcomer syndrome (ORPHA:1563).